- Abnormal nail morphology (HP:0001597): Abnormal structure or appearance of the nail. Evidence: IEA. (OMIM:161080)
- Autosomal dominant inheritance (HP:0000006): A mode of inheritance that is observed for traits related to a gene encoded on one of the autosomes (i.e., the human chromosomes 1-22) in which a trait manifests in heterozygotes. In the context of medical genetics, an autosomal dominant disorder is caused when a single copy of the mutant allele is present. Males and females are affected equally, and can both transmit the disorder with a risk of 50% for each child of inheriting the mutant allele. Evidence: IEA. (OMIM:161080)
These phenotypes are associated with the disease NAIL LOW-SULFUR PROTEIN (OMIM:161080).